- Abnormal mandible morphology (HP:0000277): Any abnormality of the mandible, the bone of the lower jaw. Evidence: TAS. Frequency: Frequent (HP:0040282). (ORPHA:93958)
- Depression (HP:0000716): Frequently experiencing feelings of being down, miserable, and/or hopeless; struggling to recover from these moods; having a pessimistic outlook on the future; feeling a pervasive sense of shame; having a low self-worth; experiencing thoughts of suicide and engaging in suicidal behavior. Evidence: TAS. Frequency: Frequent (HP:0040282). (ORPHA:93958)
- Dysphonia (HP:0001618): Difficulty in speaking due to a physical disorder of the mouth, tongue, throat, or vocal cords. Associated with a known physical or neurological cause. Evidence: TAS. Frequency: Frequent (HP:0040282). (ORPHA:93958)
- Weight loss (HP:0001824): Reduction of total body weight. Evidence: TAS. Frequency: Frequent (HP:0040282). (ORPHA:93958)
- Dysphagia (HP:0002015): Difficulty in swallowing. Evidence: TAS. Frequency: Frequent (HP:0040282). (ORPHA:93958)
- Impaired mastication (HP:0005216): An abnormal reduction in the ability to masticate (chew), i.e., in the ability to crush and ground food in preparation for swallowing. Evidence: TAS. Frequency: Frequent (HP:0040282). (ORPHA:93958)
- Abnormality of the temporomandibular joint (HP:0010754): An anomaly of the temporomandibular joint. Evidence: TAS. Frequency: Frequent (HP:0040282). (ORPHA:93958)
- Pain (HP:0012531): An unpleasant sensory and emotional experience associated with actual or potential tissue damage, or described in terms of such damage. Evidence: TAS. Frequency: Frequent (HP:0040282). (ORPHA:93958)
- Abnormal lip morphology (HP:0000159): An abnormality of the lip. Evidence: TAS. Frequency: Occasional (HP:0040283). (ORPHA:93958)
- Facial grimacing (HP:0000273). Evidence: TAS. Frequency: Occasional (HP:0040283). (ORPHA:93958)
- Abnormality of the nose (HP:0000366): An abnormality of the nose. Evidence: TAS. Frequency: Occasional (HP:0040283). (ORPHA:93958)
- Torticollis (HP:0000473): Involuntary contractions of the neck musculature resulting in an abnormal posture of or abnormal movements of the head. Evidence: TAS. Frequency: Occasional (HP:0040283). (ORPHA:93958)
- Blepharospasm (HP:0000643): A focal dystonia that affects the muscles of the eyelids and brow, associated with involuntary recurrent spasm of both eyelids. Evidence: TAS. Frequency: Occasional (HP:0040283). (ORPHA:93958)
- Hyperkinetic movements (HP:0002487): Motor hyperactivity with excessive movement of muscles of the body as a whole. Evidence: TAS. Frequency: Occasional (HP:0040283). (ORPHA:93958)
- Bruxism (HP:0003763): Bruxism is characterized by the grinding of the teeth including the clenching of the jaw and typically occur during sleep. Evidence: TAS. Frequency: Occasional (HP:0040283). (ORPHA:93958)
- Generalized dystonia (HP:0007325): A type of dystonia that affects all or most of the body. Evidence: TAS. Frequency: Occasional (HP:0040283). (ORPHA:93958)
- Laryngeal dystonia (HP:0012049): A form of focal dystonia that affects the vocal cords, associated with involuntary contractions of the vocal cords causing interruptions of speech and affecting the voice quality and often leading to patterned, repeated breaks in speech. Evidence: TAS. Frequency: Occasional (HP:0040283). (ORPHA:93958)
- Lingual dystonia (HP:0031008): Involuntary protrusions, movements, spams and contortions of the tongue. Evidence: TAS. Frequency: Occasional (HP:0040283). (ORPHA:93958)
- Dysarthria (HP:0001260): Dysarthric speech is a general description referring to a neurological speech disorder characterized by poor articulation. Depending on the involved neurological structures, dysarthria may be further classified as spastic, flaccid, ataxic, hyperkinetic and hypokinetic, or mixed. Evidence: TAS. Frequency: Very rare (HP:0040284). (ORPHA:93958)
- Respiratory distress (HP:0002098): Respiratory distress is objectively observable as the physical or emotional consequences from the experience of dyspnea. The physical presentation of respiratory distress is generally referred to as labored breathing, while the sensation of respiratory distress is called shortness of breath or dyspnea. Evidence: TAS. Frequency: Very rare (HP:0040284). (ORPHA:93958)
- Limb dystonia (HP:0002451): A type of dystonia (abnormally increased muscular tone causing fixed abnormal postures) that affects muscles of the limbs. Evidence: TAS. Frequency: Very rare (HP:0040284). (ORPHA:93958)
These phenotypes are associated with the disease Oromandibular dystonia (ORPHA:93958).